- Multiple exostoses (HP:0002762): Presence of more than one exostosis. An exostosis is a benign growth the projects outward from the bone surface. It is capped by cartilage, and arises from a bone that develops from cartilage. Evidence: PCS. Frequency: 17/17. (PMID:8782816;PMID:11432960)
- Juvenile onset (HP:0003621): Onset of signs or symptoms of disease between the age of 5 and 15 years. Evidence: PCS. Frequency: 3/9. (PMID:11432960)
- Madelung-like forearm deformities (HP:0003068). Evidence: IEA. (OMIM:133701)
- Short stature (HP:0004322): A height below that which is expected according to age and gender norms. Although there is no universally accepted definition of short stature, many refer to "short stature" as height more than 2 standard deviations below the mean for age and gender (or below the 3rd percentile for age and gender dependent norms). Evidence: IEA. Frequency: 0/10. (OMIM:133701)
- Pelvic bone exostoses (HP:0003276): A benign growth the projects outward from the bone surface of the pelvis. Exostoses are capped by cartilage, and arise from a bone that develops from cartilage. Evidence: IEA. (OMIM:133701)
- Infantile onset (HP:0003593): Onset of signs or symptoms of disease between 28 days to one year of life. Evidence: IEA. Frequency: 1/9. (PMID:11432960)
- Short metacarpal (HP:0010049): Diminished length of one or more metacarpal bones in relation to the others of the same hand or to the contralateral metacarpal. Evidence: IEA. (OMIM:133701)
- Scapular exostoses (HP:0000918): The presence of multiple exostoses on the scapula. An exostosis is a benign growth the projects outward from the bone surface. It is capped by cartilage. Evidence: IEA. (OMIM:133701)
- Childhood onset (HP:0011463): Onset of disease at the age of between 1 and 5 years. Evidence: PCS. Frequency: 5/9. (PMID:11432960)
- Coxa vara (HP:0002812): Coxa vara includes all forms of decrease of the femoral neck shaft angle (the angle between the neck and the shaft of the femur) to less than 120 degrees. Evidence: IEA. (OMIM:133701)
- Peripheral nerve compression (HP:0003406). Evidence: IEA. (OMIM:133701)
- Cervical myelopathy (HP:0002318): A collection of pathologic conditions that result from progressive spinal cord dysfunction secondary to cord compression in the cervical spine. Evidence: IEA. (OMIM:133701)
- Genu valgum (HP:0002857): The legs angle inward, such that the knees are close together and the ankles far apart. Evidence: IEA. (OMIM:133701)
- Chondrosarcoma (HP:0006765): A slowly growing malignant neoplasm derived from cartilage cells. Evidence: PCS. Frequency: 1/18. (PMID:8782816;PMID:11432960)
- Autosomal dominant inheritance (HP:0000006): A mode of inheritance that is observed for traits related to a gene encoded on one of the autosomes (i.e., the human chromosomes 1-22) in which a trait manifests in heterozygotes. In the context of medical genetics, an autosomal dominant disorder is caused when a single copy of the mutant allele is present. Males and females are affected equally, and can both transmit the disorder with a risk of 50% for each child of inheriting the mutant allele. Evidence: PCS. (PMID:8782816)
- Protuberances at ends of long bones (HP:0003105): The presence of multiple protuberances (bulges, or knobs) at the ends of the long bones. Evidence: IEA. (OMIM:133701)
- Rib exostoses (HP:0000896): Multiple circumscribed bony excrescences located in the ribs. Evidence: IEA. (OMIM:133701)
These phenotypes are associated with the disease exostoses, multiple, type 2 (OMIM:133701).